Phenotypes associated with the disease Fuchs endothelial corneal dystrophy (ORPHA:98974):
- Edema (HP:0000969): An abnormal accumulation of fluid beneath the skin, or in one or more cavities of the body. Evidence: TAS. Frequency: Very frequent (HP:0040281). (ORPHA:98974)
- Reduced visual acuity (HP:0007663). Evidence: TAS. Frequency: Very frequent (HP:0040281). (ORPHA:98974)
- Corneal opacity (HP:0007957): A reduction of corneal clarity. Evidence: TAS. Frequency: Very frequent (HP:0040281). (ORPHA:98974)
- Abnormal corneal endothelium morphology (HP:0011488): Abnormality of the corneal endothelium, that is, the single layer of cells on the inner surface of the cornea. Evidence: TAS. Frequency: Very frequent (HP:0040281). (ORPHA:98974)
- Abnormal Descemet membrane morphology (HP:0011490): Abnormality of Descemet's membrane, which is the basement membrane of the corneal endothelium. Evidence: TAS. Frequency: Very frequent (HP:0040281). (ORPHA:98974)
- Reduced number of corneal endothelial cells (HP:0011491): A reduction in the number of corneal endothelial cells. Evidence: TAS. Frequency: Very frequent (HP:0040281). (ORPHA:98974)
- Visual loss (HP:0000572): Loss of visual acuity (implying that vision was better at a certain time point in life). Otherwise the term reduced visual acuity should be used (or a subclass of that). Evidence: TAS. Frequency: Frequent (HP:0040282). (ORPHA:98974)
- Nyctalopia (HP:0000662): Inability to see well at night or in poor light. Evidence: TAS. Frequency: Frequent (HP:0040282). (ORPHA:98974)
- Eye movement-induced pain (HP:0030857): An unpleasant sensation characterized by physical discomfort (such as pricking, throbbing, or aching) localized to the eye that is worse in certain directions of gaze and during prolonged gaze holding. Evidence: TAS. Frequency: Frequent (HP:0040282). (ORPHA:98974)